Phenotypes associated with the disease granular corneal dystrophy type I (OMIM:121900):
- Granular corneal dystrophy (HP:0007802): The presence of central, fine, whitish granular lesions in the stroma of the cornea. This type of corneal dystrophy is usually asymptomatic and begins in childhood and shows a slow progression. Later in the course, the corneal epithelium and Bowman's layer may be affected. Histologically, the cornea shows a uniform deposition of hyaline material. Evidence: IEA. (OMIM:121900)
- Strabismus (HP:0000486): A misalignment of the eyes so that the visual axes deviate from bifoveal fixation. The classification of strabismus may be based on a number of features including the relative position of the eyes, whether the deviation is latent or manifest, intermittent or constant, concomitant or otherwise and according to the age of onset and the relevance of any associated refractive error. Evidence: IEA. (OMIM:121900)
- Nodular corneal dystrophy (HP:0007827). Evidence: IEA. (OMIM:121900)
- Cataract (HP:0000518): A cataract is an opacity or clouding that develops in the crystalline lens of the eye or in its capsule. Evidence: IEA. (OMIM:121900)
- Punctate corneal dystrophy (HP:0007809). Evidence: IEA. (OMIM:121900)
- Autosomal dominant inheritance (HP:0000006): A mode of inheritance that is observed for traits related to a gene encoded on one of the autosomes (i.e., the human chromosomes 1-22) in which a trait manifests in heterozygotes. In the context of medical genetics, an autosomal dominant disorder is caused when a single copy of the mutant allele is present. Males and females are affected equally, and can both transmit the disorder with a risk of 50% for each child of inheriting the mutant allele. Evidence: PCS. (PMID:9054935)